- Decreased sialylation of O-linked protein glycosylation (HP:0012363): An reduced addition of sialic acids to O-linked glycans. Evidence: TAS. Frequency: Very frequent (HP:0040281). (ORPHA:263494)
- Diminished deep tendon reflex (HP:0001315): A reduction (hyporeflexia) or complete absence (areflexia) of the involuntary muscle contraction normally elicited by a reflex stimulus, such as tapping a deep tendon. Evidence: TAS. Frequency: Frequent (HP:0040282). (ORPHA:263494)
- Muscle weakness (HP:0001324): Reduced strength of muscles. Evidence: TAS. Frequency: Frequent (HP:0040282). (ORPHA:263494)
- Dilated cardiomyopathy (HP:0001644): Dilated cardiomyopathy (DCM) is defined by the presence of left ventricular dilatation and left ventricular systolic dysfunction in the absence of abnormal loading conditions (hypertension, valve disease) or coronary artery disease sufficient to cause global systolic impairment. Right ventricular dilation and dysfunction may be present but are not necessary for the diagnosis. Evidence: TAS. Frequency: Frequent (HP:0040282). (ORPHA:263494)
- Pes planus (HP:0001763): A foot where the longitudinal arch of the foot is in contact with the ground or floor when the individual is standing; or, in a patient lying supine, a foot where the arch is in contact with the surface of a flat board pressed against the sole of the foot by the examiner with a pressure similar to that expected from weight bearing; or, the height of the arch is reduced. Evidence: TAS. Frequency: Frequent (HP:0040282). (ORPHA:263494)
- Profound intellectual disability (HP:0002187): Profound intellectual disability (ID) is defined as a type of ID characterized by profoundly sub-average adaptive functioning and intellectual functioning, with an intelligence quotient (IQ) below 20. Evidence: TAS. Frequency: Frequent (HP:0040282). (ORPHA:263494)
- Stroke-like episode (HP:0002401): No consensus exists on what a stroke-like episode is, but these episodes can be functionally defined as a new neurological deficit, occurring with or without the context of seizures, which last longer than 24 hours. Evidence: TAS. Frequency: Frequent (HP:0040282). (ORPHA:263494)
- Elevated circulating hepatic transaminase concentration (HP:0002910): Elevations of the levels of SGOT and SGPT in the serum. SGOT (serum glutamic oxaloacetic transaminase) and SGPT (serum glutamic pyruvic transaminase) are transaminases primarily found in the liver and heart and are released into the bloodstream as the result of liver or heart damage. SGOT and SGPT are used clinically mainly as markers of liver damage. Evidence: TAS. Frequency: Frequent (HP:0040282). (ORPHA:263494)
- Babinski sign (HP:0003487): Upturning of the big toe (and sometimes fanning of the other toes) in response to stimulation of the sole of the foot. If the Babinski sign is present it can indicate damage to the corticospinal tract. Evidence: TAS. Frequency: Frequent (HP:0040282). (ORPHA:263494)
- Muscular dystrophy (HP:0003560): The term dystrophy means abnormal growth. However, muscular dystrophy is used to describe primary myopathies with a genetic basis and a progressive course characterized by progressive skeletal muscle weakness and wasting, defects in muscle proteins, and histological features of muscle fiber degeneration (necrosis) and regeneration. If possible, it is preferred to use other HPO terms to describe the precise phenotypic abnormalities. Evidence: TAS. Frequency: Frequent (HP:0040282). (ORPHA:263494)
- Pelvic girdle muscle weakness (HP:0003749): Weakness of the muscles of the pelvic girdle (also known as the hip girdle), that is, lack of strength of the muscles around the pelvis. Evidence: TAS. Frequency: Frequent (HP:0040282). (ORPHA:263494)
- Rimmed vacuoles (HP:0003805): Presence of abnormal vacuoles (membrane-bound organelles) in the sarcolemma. On histological staining with hematoxylin and eosin, rimmed vacuoles are popcorn-like clear vacuoles with a densely blue rim. The vacuoles are often associated with cytoplasmic and occasionally intranuclear eosinophilic inclusions. Evidence: TAS. Frequency: Frequent (HP:0040282). (ORPHA:263494)
- Elevated creatine kinase after exercise (HP:0008331). Evidence: TAS. Frequency: Frequent (HP:0040282). (ORPHA:263494)
- Calf muscle hypertrophy (HP:0008981): Muscle hypertrophy affecting the calf muscles. Evidence: TAS. Frequency: Frequent (HP:0040282). (ORPHA:263494)
- Chest pain (HP:0100749): An unpleasant sensation characterized by physical discomfort (such as pricking, throbbing, or aching) localized to the chest. Evidence: TAS. Frequency: Frequent (HP:0040282). (ORPHA:263494)
These phenotypes are associated with the disease DPM3-CDG (ORPHA:263494).